- Parkinsonism (HP:0001300): Characteristic neurologic anomaly resulting from degeneration of dopamine-generating cells in the substantia nigra, a region of the midbrain, characterized clinically by shaking, rigidity, slowness of movement and difficulty with walking and gait. Evidence: IEA. (OMIM:502500)
- Dementia (HP:0000726): A loss of global cognitive ability of sufficient amount to interfere with normal social or occupational function. Dementia represents a loss of previously present cognitive abilities, generally in adults, and can affect memory, thinking, language, judgment, and behavior. Evidence: IEA. (OMIM:502500)
- Late onset (HP:0003584): A type of adult onset with onset of symptoms after the age of 60 years. Evidence: IEA. (OMIM:502500)
- Neurofibrillary tangles (HP:0002185): Pathological protein aggregates formed by hyperphosphorylation of a microtubule-associated protein known as tau, causing it to aggregate in an insoluble form. Evidence: IEA. (OMIM:502500)
- Mitochondrial inheritance (HP:0001427): A mode of inheritance that is observed for traits related to a gene encoded on the mitochondrial genome. Because the mitochondrial genome is essentially always maternally inherited, a mitochondrial condition can only be transmitted by females, although the condition can affect both sexes. The proportion of mutant mitochondria can vary (heteroplasmy). Evidence: TAS. (OMIM:502500)
- Long-tract sign (HP:0002423): Long-tract signs refer to symptoms that are attributable to the involvement of the long fiber tracts in the spinal cord, which connect the spinal cord to the brain and mediate spinal and motor functions. These include spasticity, hyperreflexia, and abnormal reflexes such as Babinski or Hoffman's sign. If possible, it is preferable to use the precise HPO terms for these abnormalities. Evidence: IEA. (OMIM:502500)
- Alzheimer disease (HP:0002511): A degenerative disease of the brain characterized by the insidious onset of dementia. Impairment of memory, judgment, attention span, and problem solving skills are followed by severe apraxia and a global loss of cognitive abilities. The condition primarily occurs after age 60, and is marked pathologically by severe cortical atrophy and the triad of senile plaques, neurofibrillary tangles, and neuropil threads. Evidence: IEA. (OMIM:502500)
- Autosomal dominant inheritance (HP:0000006): A mode of inheritance that is observed for traits related to a gene encoded on one of the autosomes (i.e., the human chromosomes 1-22) in which a trait manifests in heterozygotes. In the context of medical genetics, an autosomal dominant disorder is caused when a single copy of the mutant allele is present. Males and females are affected equally, and can both transmit the disorder with a risk of 50% for each child of inheriting the mutant allele. Evidence: TAS. (OMIM:502500)
These phenotypes are associated with the disease Alzheimer disease, susceptibility to, mitochondrial (OMIM:502500).